Phenotypes associated with the disease Mowat-Wilson syndrome (ORPHA:2152):
- Reduced social responsiveness (HP:0012760): A reduced ability to participate in the back-and-forth flow of social interaction appropriate to culture and developmental level, which is normally characterized by an influence of the behavior of one person on the behavior of another person. This results in difficulty interacting with others through emotional, physical, or verbal communication. Evidence: TAS. Frequency: Occasional (HP:0040283). (ORPHA:2152)
- Delayed ability to walk (HP:0031936): A failure to achieve the ability to walk at an appropriate developmental stage. Most children learn to walk in a series of stages, and learn to walk short distances independently between 12 and 15 months. Evidence: TAS. Frequency: Frequent (HP:0040282). (ORPHA:2152)
- Happy demeanor (HP:0040082): A conspicuously happy disposition, characterized by frequent smiling and laughing, which may be contextually inappropriate or unrelated to the situation. Evidence: TAS. Frequency: Frequent (HP:0040282). (ORPHA:2152)
- Multicystic kidney dysplasia (HP:0000003): Multicystic dysplasia of the kidney is characterized by multiple cysts of varying size in the kidney and the absence of a normal pelvicaliceal system. The condition is associated with ureteral or ureteropelvic atresia, and the affected kidney is nonfunctional. Evidence: TAS. Frequency: Occasional (HP:0040283). (ORPHA:2152)
- Renal duplication (HP:0000075): A congenital anomaly of the urinary tract, in which the kidney is duplicated and is drained via two separate renal pelves and ureters. Evidence: TAS. Frequency: Occasional (HP:0040283). (ORPHA:2152)
- Vesicoureteral reflux (HP:0000076): Abnormal (retrograde) movement of urine from the bladder into ureters or kidneys related to inadequacy of the valvular mechanism at the ureterovesicular junction or other causes. Evidence: TAS. Frequency: Occasional (HP:0040283). (ORPHA:2152)
- Abnormality of the kidney (HP:0000077): An abnormality of the kidney. Evidence: TAS. Frequency: Occasional (HP:0040283). (ORPHA:2152)
- Pelvic kidney (HP:0000125): A developmental defect in which a kidney is located in an abnormal anatomic position within the pelvis. Evidence: TAS. Frequency: Occasional (HP:0040283). (ORPHA:2152)
- Hydronephrosis (HP:0000126): Severe distention of the kidney with dilation of the renal pelvis and calices. Evidence: TAS. Frequency: Occasional (HP:0040283). (ORPHA:2152)
- Gingival overgrowth (HP:0000212): Hyperplasia of the gingiva (that is, a thickening of the soft tissue overlying the alveolar ridge. The degree of thickening ranges from involvement of the interdental papillae alone to gingival overgrowth covering the entire tooth crown. Evidence: TAS. Frequency: Occasional (HP:0040283). (ORPHA:2152)
- Conductive hearing impairment (HP:0000405): An abnormality of vibrational conductance of sound to the inner ear leading to impairment of sensory perception of sound. Evidence: TAS. Frequency: Occasional (HP:0040283). (ORPHA:2152)
- Abnormality of the eye (HP:0000478): Any abnormality of the eye, including location, spacing, and intraocular abnormalities. Evidence: TAS. Frequency: Occasional (HP:0040283). (ORPHA:2152)
- Retinal coloboma (HP:0000480): A notch or cleft of the retina or choroid, located vertically below the optic disc. Evidence: TAS. Frequency: Occasional (HP:0040283). (ORPHA:2152)
- Astigmatism (HP:0000483): A type of refraction error associated with abnormal curvatures on the anterior and/or posterior surface of the cornea. Evidence: TAS. Frequency: Occasional (HP:0040283). (ORPHA:2152)
- Cataract (HP:0000518): A cataract is an opacity or clouding that develops in the crystalline lens of the eye or in its capsule. Evidence: TAS. Frequency: Occasional (HP:0040283). (ORPHA:2152)
- Myopia (HP:0000545): An abnormality of refraction characterized by the ability to see objects nearby clearly, while objects in the distance appear blurry. Evidence: TAS. Frequency: Occasional (HP:0040283). (ORPHA:2152)
- Microphthalmia (HP:0000568): A developmental anomaly characterized by abnormal smallness of one or both eyes. Evidence: TAS. Frequency: Occasional (HP:0040283). (ORPHA:2152)
- Iris coloboma (HP:0000612): A coloboma of the iris. Evidence: TAS. Frequency: Occasional (HP:0040283). (ORPHA:2152)
- Nystagmus (HP:0000639): Rhythmic, involuntary oscillations of one or both eyes related to abnormality in fixation, conjugate gaze, or vestibular mechanisms. Evidence: TAS. Frequency: Occasional (HP:0040283). (ORPHA:2152)
- Dental crowding (HP:0000678): Changes in alignment of teeth in the dental arch. Evidence: TAS. Frequency: Occasional (HP:0040283). (ORPHA:2152)
- Delayed eruption of teeth (HP:0000684): Delayed tooth eruption, which can be defined as tooth eruption more than 2 SD beyond the mean eruption age. Evidence: TAS. Frequency: Occasional (HP:0040283). (ORPHA:2152)
- Widely spaced teeth (HP:0000687): Increased spaces (diastemata) between most of the teeth in the same dental arch. Evidence: TAS. Frequency: Occasional (HP:0040283). (ORPHA:2152)
- Tooth malposition (HP:0000692): Abnormal alignment, positioning, or spacing of the teeth, i.e., misaligned teeth. Evidence: TAS. Frequency: Occasional (HP:0040283). (ORPHA:2152)
- Anxiety (HP:0000739): Intense feelings of nervousness, tension, or panic often arise in response to interpersonal stresses. There is worry about the negative effects of past unpleasant experiences and future negative possibilities. Individuals may feel fearful, apprehensive, or threatened by uncertainty, and they may also have fears of falling apart or losing control. Evidence: TAS. Frequency: Occasional (HP:0040283). (ORPHA:2152)
- Adducted thumb (HP:0001181): In the resting position, the tip of the thumb is on, or near, the palm, close to the base of the fourth or fifth finger. Evidence: TAS. Frequency: Occasional (HP:0040283). (ORPHA:2152)
- Tapered finger (HP:0001182): The gradual reduction in girth of the finger from proximal to distal. Evidence: TAS. Frequency: Occasional (HP:0040283). (ORPHA:2152)
- Ataxia (HP:0001251): Ataxia refers to impaired coordination of voluntary muscle movement. Cerebellar ataxia refers to ataxia due to dysfunction of the cerebellum. This causes a variety of elementary neurological deficits including asynergy (lack of coordination between muscles, limbs and joints), dysmetria (lack of ability to judge distances that can lead to under- or overshoot in grasping movements), and dysdiadochokinesia (inability to perform rapid movements requiring antagonizing muscle groups to be switched on and off repeatedly). Evidence: TAS. Frequency: Occasional (HP:0040283). (ORPHA:2152)
- Hypotonia (HP:0001252): Hypotonia is an abnormally low muscle tone (the amount of tension or resistance to movement in a muscle). Even when relaxed, muscles have a continuous and passive partial contraction which provides some resistance to passive stretching. Hypotonia thus manifests as diminished resistance to passive stretching. Hypotonia is not the same as muscle weakness, although the two conditions can co-exist. Evidence: TAS. Frequency: Occasional (HP:0040283). (ORPHA:2152)
- Spasticity (HP:0001257): A motor disorder characterized by a velocity-dependent increase in tonic stretch reflexes with increased muscle tone, exaggerated (hyperexcitable) tendon reflexes. Evidence: TAS. Frequency: Occasional (HP:0040283). (ORPHA:2152)
- Cerebellar vermis hypoplasia (HP:0001320): Underdevelopment of the vermis of cerebellum. Evidence: TAS. Frequency: Occasional (HP:0040283). (ORPHA:2152)
- Hypospadias (HP:0000047): Abnormal position of urethral meatus on the ventral penile shaft (underside) characterized by displacement of the urethral meatus from the tip of the glans penis to the ventral surface of the penis, scrotum, or perineum. Evidence: TAS. Frequency: Frequent (HP:0040282). (ORPHA:2152)
- Thick lower lip vermilion (HP:0000179): Increased thickness of the lower lip, leading to a prominent appearance of the lower lip. The height of the vermilion of the lower lip in the midline is more than 2 SD above the mean. Alternatively, an apparently increased height of the vermilion of the lower lip in the frontal view (subjective). Evidence: TAS. Frequency: Frequent (HP:0040282). (ORPHA:2152)
- Open mouth (HP:0000194): A facial appearance characterized by a permanently or nearly permanently opened mouth. Evidence: TAS. Frequency: Frequent (HP:0040282). (ORPHA:2152)
- Everted lower lip vermilion (HP:0000232): An abnormal configuration of the lower lip such that it is turned outward i.e., everted, with the Inner aspect of the lower lip vermilion (normally opposing the teeth) being visible in a frontal view. Evidence: TAS. Frequency: Frequent (HP:0040282). (ORPHA:2152)
- Microcephaly (HP:0000252): Head circumference below 2 standard deviations below the mean for age and gender. Evidence: TAS. Frequency: Frequent (HP:0040282). (ORPHA:2152)
- Long face (HP:0000276): Facial height (length) is more than 2 standard deviations above the mean (objective); or, an apparent increase in the height (length) of the face (subjective). Evidence: TAS. Frequency: Frequent (HP:0040282). (ORPHA:2152)
- Mandibular prognathia (HP:0000303): Abnormal prominence of the chin related to increased length of the mandible. Evidence: TAS. Frequency: Frequent (HP:0040282). (ORPHA:2152)
- Pointed chin (HP:0000307): A marked tapering of the lower face to the chin. Evidence: TAS. Frequency: Frequent (HP:0040282). (ORPHA:2152)
- Hypertelorism (HP:0000316): Interpupillary distance more than 2 SD above the mean (alternatively, the appearance of an increased interpupillary distance or widely spaced eyes). Evidence: TAS. Frequency: Frequent (HP:0040282). (ORPHA:2152)
- Posteriorly rotated ears (HP:0000358): A type of abnormal location of the ears in which the position of the ears is characterized by posterior rotation (the superior part of the ears is rotated towards the back of the head, and the inferior part of the ears towards the front). Evidence: TAS. Frequency: Frequent (HP:0040282). (ORPHA:2152)
- Recurrent otitis media (HP:0000403): Increased susceptibility to otitis media, as manifested by recurrent episodes of otitis media. Evidence: TAS. Frequency: Frequent (HP:0040282). (ORPHA:2152)
- Wide nasal bridge (HP:0000431): Increased breadth of the nasal bridge (and with it, the nasal root). Evidence: TAS. Frequency: Frequent (HP:0040282). (ORPHA:2152)
- Depressed nasal tip (HP:0000437): Decreased distance from the nasal tip to the nasal base. Evidence: TAS. Frequency: Frequent (HP:0040282). (ORPHA:2152)
- Strabismus (HP:0000486): A misalignment of the eyes so that the visual axes deviate from bifoveal fixation. The classification of strabismus may be based on a number of features including the relative position of the eyes, whether the deviation is latent or manifest, intermittent or constant, concomitant or otherwise and according to the age of onset and the relevance of any associated refractive error. Evidence: TAS. Frequency: Frequent (HP:0040282). (ORPHA:2152)
- Deeply set eye (HP:0000490): An eye that is more deeply recessed into the plane of the face than is typical. Evidence: TAS. Frequency: Frequent (HP:0040282). (ORPHA:2152)
- Telecanthus (HP:0000506): Distance between the inner canthi more than two standard deviations above the mean (objective); or, apparently increased distance between the inner canthi. Evidence: TAS. Frequency: Frequent (HP:0040282). (ORPHA:2152)
- Motor stereotypy (HP:0000733): Use of the same abnormal action in response to certain triggers or at random. They may be used as a way to regulate one's internal state but must otherwise have no apparent functional purpose. Evidence: TAS. Frequency: Frequent (HP:0040282). (ORPHA:2152)
- Pectus excavatum (HP:0000767): A defect of the chest wall characterized by a depression of the sternum, giving the chest ("pectus") a caved-in ("excavatum") appearance. Evidence: TAS. Frequency: Frequent (HP:0040282). (ORPHA:2152)
- Pectus carinatum (HP:0000768): A deformity of the chest caused by overgrowth of the ribs and characterized by protrusion of the sternum. Evidence: TAS. Frequency: Frequent (HP:0040282). (ORPHA:2152)
- Syndactyly (HP:0001159): Webbing or fusion of the fingers or toes, involving soft parts only or including bone structure. Bony fusions are referred to as "bony" syndactyly if the fusion occurs in a radio-ulnar axis. Fusions of bones of the fingers or toes in a proximo-distal axis are referred to as "symphalangism". Evidence: TAS. Frequency: Frequent (HP:0040282). (ORPHA:2152)
- Seizure (HP:0001250): A seizure is an intermittent abnormality of nervous system physiology characterized by a transient occurrence of signs and/or symptoms due to abnormal excessive or synchronous neuronal activity in the brain. Evidence: TAS. Frequency: Frequent (HP:0040282). (ORPHA:2152)
- Agenesis of corpus callosum (HP:0001274): Absence of the corpus callosum as a result of the failure of the corpus callosum to develop, which can be the result of a failure in any one of the multiple steps of callosal development including cellular proliferation and migration, axonal growth or glial patterning at the midline. Evidence: TAS. Frequency: Frequent (HP:0040282). (ORPHA:2152)
- Flexion contracture (HP:0001371): A flexion contracture is a bent (flexed) joint that cannot be straightened actively or passively. It is thus a chronic loss of joint motion due to structural changes in muscle, tendons, ligaments, or skin that prevents normal movement of joints. Evidence: TAS. Frequency: Frequent (HP:0040282). (ORPHA:2152)
- Growth delay (HP:0001510): A deficiency or slowing down of growth pre- and postnatally. Evidence: TAS. Frequency: Frequent (HP:0040282). (ORPHA:2152)
- Abnormal heart morphology (HP:0001627): Any structural anomaly of the heart. Evidence: TAS. Frequency: Frequent (HP:0040282). (ORPHA:2152)
- Patent ductus arteriosus (HP:0001643): In utero, the ductus arteriosus (DA) serves to divert ventricular output away from the lungs and toward the placenta by connecting the main pulmonary artery to the descending aorta. A patent ductus arteriosus (PDA) in the first 3 days of life is a physiologic shunt in healthy term and preterm newborn infants, and normally is substantially closed within about 24 hours after bith and completely closed after about three weeks. Failure of physiologcal closure is referred to a persistent or patent ductus arteriosus (PDA). Depending on the degree of left-to-right shunting, PDA can have clinical consequences. Evidence: TAS. Frequency: Frequent (HP:0040282). (ORPHA:2152)
- Abnormal cardiac septum morphology (HP:0001671): An anomaly of the intra-atrial or intraventricular septum. Evidence: TAS. Frequency: Frequent (HP:0040282). (ORPHA:2152)
- Pes planus (HP:0001763): A foot where the longitudinal arch of the foot is in contact with the ground or floor when the individual is standing; or, in a patient lying supine, a foot where the arch is in contact with the surface of a flat board pressed against the sole of the foot by the examiner with a pressure similar to that expected from weight bearing; or, the height of the arch is reduced. Evidence: TAS. Frequency: Frequent (HP:0040282). (ORPHA:2152)
- Hallux valgus (HP:0001822): Lateral deviation of the great toe (i.e., in the direction of the little toe). Evidence: TAS. Frequency: Frequent (HP:0040282). (ORPHA:2152)
- Morphological central nervous system abnormality (HP:0002011): A structural abnormality of the central nervous system. Evidence: TAS. Frequency: Frequent (HP:0040282). (ORPHA:2152)
- Hypoplasia of the corpus callosum (HP:0002079): Underdevelopment of the corpus callosum. Evidence: TAS. Frequency: Frequent (HP:0040282). (ORPHA:2152)
- Broad-based gait (HP:0002136): An abnormal gait pattern in which persons stand and walk with their feet spaced widely apart. This is often a component of cerebellar ataxia. Evidence: TAS. Frequency: Frequent (HP:0040282). (ORPHA:2152)
- Aganglionic megacolon (HP:0002251): An abnormality resulting from a lack of intestinal ganglion cells (i.e., an aganglionic section of bowel) that results in bowel obstruction with enlargement of the colon. Evidence: TAS. Frequency: Frequent (HP:0040282). (ORPHA:2152)
- Moderate intellectual disability (HP:0002342): Moderate intellectual disability (ID) is defined as a type of ID characterized by moderately sub-average adaptive functioning and intellectual functioning, with an intelligence quotient (IQ) the range of 35-49. Evidence: TAS. Frequency: Frequent (HP:0040282). (ORPHA:2152)
- Sleep disturbance (HP:0002360): An abnormal pattern in the quality, quantity, or characteristics of sleep. Evidence: TAS. Frequency: Frequent (HP:0040282). (ORPHA:2152)
- Expressive aphasia (HP:0002427): Impairment of expressive language and relative preservation of receptive language abilities. That is, the patient understands language (speech, writing) but cannot express it. Evidence: TAS. Frequency: Frequent (HP:0040282). (ORPHA:2152)
- Bowel incontinence (HP:0002607): Involuntary fecal soiling in adults and children who have usually already been toilet trained. Evidence: TAS. Frequency: Frequent (HP:0040282). (ORPHA:2152)
- Scoliosis (HP:0002650): The presence of an abnormal lateral curvature of the spine. Evidence: TAS. Frequency: Frequent (HP:0040282). (ORPHA:2152)
- Delayed skeletal maturation (HP:0002750): A decreased rate of skeletal maturation. Delayed skeletal maturation can be diagnosed on the basis of an estimation of the bone age from radiographs of specific bones in the human body. Evidence: TAS. Frequency: Frequent (HP:0040282). (ORPHA:2152)
- Genu valgum (HP:0002857): The legs angle inward, such that the knees are close together and the ankles far apart. Evidence: TAS. Frequency: Frequent (HP:0040282). (ORPHA:2152)
- Short stature (HP:0004322): A height below that which is expected according to age and gender norms. Although there is no universally accepted definition of short stature, many refer to "short stature" as height more than 2 standard deviations below the mean for age and gender (or below the 3rd percentile for age and gender dependent norms). Evidence: TAS. Frequency: Frequent (HP:0040282). (ORPHA:2152)
- Decreased body weight (HP:0004325): Abnormally low body weight. Evidence: TAS. Frequency: Frequent (HP:0040282). (ORPHA:2152)
- Prominent nasal tip (HP:0005274). Evidence: TAS. Frequency: Frequent (HP:0040282). (ORPHA:2152)
- Impaired pain sensation (HP:0007328): Reduced ability to perceive painful stimuli. Evidence: TAS. Frequency: Frequent (HP:0040282). (ORPHA:2152)
- Ulnar deviation of the hand (HP:0009487): Divergence of the longitudinal axis of the hand at the wrist in a posterior (ulnar) direction (i.e., towards the little finger). Evidence: TAS. Frequency: Frequent (HP:0040282). (ORPHA:2152)
- Low hanging columella (HP:0009765): Columella extending inferior to the level of the nasal base, when viewed from the side. Evidence: TAS. Frequency: Frequent (HP:0040282). (ORPHA:2152)
- Uplifted earlobe (HP:0009909): An abnormal orientation of the earlobes such that they point out- and upward. That is, the lateral surface of ear lobe faces superiorly. Evidence: TAS. Frequency: Frequent (HP:0040282). (ORPHA:2152)
- Broad hallux (HP:0010055): Visible increase in width of the hallux without an increase in the dorso-ventral dimension. Evidence: TAS. Frequency: Frequent (HP:0040282). (ORPHA:2152)
- Long toe (HP:0010511): Toes that appear disproportionately long compared to the foot. Evidence: TAS. Frequency: Frequent (HP:0040282). (ORPHA:2152)
- Broad columella (HP:0010761): Increased width of the columella. Evidence: TAS. Frequency: Frequent (HP:0040282). (ORPHA:2152)
- EEG with generalized slow activity (HP:0010845): Diffuse slowing of cerebral electrical activity recorded along the scalp by electroencephalography (EEG). Evidence: TAS. Frequency: Frequent (HP:0040282). (ORPHA:2152)
- Delayed fine motor development (HP:0010862): A type of motor delay characterized by a delay in acquiring the ability to control the fingers and hands. Evidence: TAS. Frequency: Frequent (HP:0040282). (ORPHA:2152)
- Severe intellectual disability (HP:0010864): Severe intellectual disability (ID) is defined as a type of ID characterized by severely sub-average adaptive functioning and intellectual functioning, with an intelligence quotient (IQ) the range of 20-34. Evidence: TAS. Frequency: Frequent (HP:0040282). (ORPHA:2152)
- Horizontal eyebrow (HP:0011228): An eyebrow that extends straight across the brow, without curve. Evidence: TAS. Frequency: Frequent (HP:0040282). (ORPHA:2152)
- Broad eyebrow (HP:0011229): Regional increase in the width (height) of the eyebrow. Evidence: TAS. Frequency: Frequent (HP:0040282). (ORPHA:2152)
- Camptodactyly (HP:0012385): The distal interphalangeal joint and/or the proximal interphalangeal joint of the fingers or toes cannot be extended to 180 degrees by either active or passive extension. Evidence: TAS. Frequency: Frequent (HP:0040282). (ORPHA:2152)
- Neurodevelopmental delay (HP:0012758): Neurodevelopmental delay (NDD) refers to delays in the maturation of the brain and central nervous system; infants and young children with NDD may experience delays in the development of one or more skills including gross motor abilities, fine-motor coordination, language abilities and ability to solve increasingly complex problems. Evidence: TAS. Frequency: Frequent (HP:0040282). (ORPHA:2152)
- Axenfeld anomaly (HP:0001492): Axenfeld's anomaly is a bilateral disorder characterized by a prominent, anteriorly displaced Schwalbe's line (posterior embryotoxon) and peripheral iris strands which span the anterior chamber angle to attach to Schwalbe's line. Evidence: TAS. Frequency: Occasional (HP:0040283). (ORPHA:2152)
- Tetralogy of Fallot (HP:0001636): A congenital cardiac malformation comprising pulmonary stenosis, overriding aorta, ventricular septum defect, and right ventricular hypertrophy. The diagnosis of TOF is made if at least three of the four above mentioned features are present. Evidence: TAS. Frequency: Occasional (HP:0040283). (ORPHA:2152)
- Pulmonic stenosis (HP:0001642): A narrowing of the right ventricular outflow tract that can occur at the pulmonary valve (valvular stenosis), below the pulmonary valve (infundibular stenosis), or above the pulmonary valve (supravalvar stenosis). Evidence: TAS. Frequency: Occasional (HP:0040283). (ORPHA:2152)
- Bicuspid aortic valve (HP:0001647): The presence of an aortic valve with two instead of the normal three cusps (flaps). Bicuspid aortic valvue is a malformation of a commissure (small space between the attachment of each cusp to the aortic wall) and the adjacent parts of the two corresponding cusps forming a raphe (the fused area of the two underdeveloped cusps turning into a malformed commissure between both cusps; the raphe is a fibrous ridge that extends from the commissure to the free edge of the two underdeveloped, conjoint cusps). Evidence: TAS. Frequency: Occasional (HP:0040283). (ORPHA:2152)
- Aortic valve stenosis (HP:0001650): The presence of a stenosis (narrowing) of the aortic valve. Evidence: TAS. Frequency: Occasional (HP:0040283). (ORPHA:2152)
- Coarctation of aorta (HP:0001680): Coarctation of the aorta is a narrowing or constriction of a segment of the aorta. Evidence: TAS. Frequency: Occasional (HP:0040283). (ORPHA:2152)
- Asplenia (HP:0001746): Absence (aplasia) of the spleen. Evidence: TAS. Frequency: Occasional (HP:0040283). (ORPHA:2152)
- Calcaneovalgus deformity (HP:0001848): This is a postural deformity in which the foot is positioned up against the tibia. The heel (calcaneus) is positioned downward (that is, the ankle is flexed upward), and the heel is turned outward (valgus). Evidence: TAS. Frequency: Occasional (HP:0040283). (ORPHA:2152)
- Vomiting (HP:0002013): Forceful ejection of the contents of the stomach through the mouth by means of a series of involuntary spasmic contractions. Evidence: TAS. Frequency: Occasional (HP:0040283). (ORPHA:2152)
- Constipation (HP:0002019): Infrequent or difficult evacuation of feces. Evidence: TAS. Frequency: Occasional (HP:0040283). (ORPHA:2152)
- Pyloric stenosis (HP:0002021): Pyloric stenosis, also known as infantile hypertrophic pyloric stenosis, is an uncommon condition in infants characterized by abnormal thickening of the pylorus muscles in the stomach leading to gastric outlet obstruction. Clinically infants are well at birth. Then, at 3 to 6 weeks of age, the infants present with projectile vomiting, potentially leading to dehydration and weight loss. Evidence: TAS. Frequency: Occasional (HP:0040283). (ORPHA:2152)
- Ventriculomegaly (HP:0002119): An increase in size of the ventricular system of the brain. Evidence: TAS. Frequency: Occasional (HP:0040283). (ORPHA:2152)
- Polymicrogyria (HP:0002126): Polymicrogyria is a congenital malformation of the cerebral cortex characterized by abnormal cortical layering (lamination) and an excessive number of small gyri (folds). Evidence: TAS. Frequency: Occasional (HP:0040283). (ORPHA:2152)
- Status epilepticus (HP:0002133): Status epilepticus is a type of prolonged seizure resulting either from the failure of the mechanisms responsible for seizure termination or from the initiation of mechanisms which lead to abnormally prolonged seizures (after time point t1). It is a condition that can have long-term consequences (after time point t2), including neuronal death, neuronal injury, and alteration of neuronal networks, depending on the type and duration of seizures. Evidence: TAS. Frequency: Occasional (HP:0040283). (ORPHA:2152)
- Agenesis of cerebellar vermis (HP:0002335): Congenital absence of the vermis of cerebellum. Evidence: TAS. Frequency: Occasional (HP:0040283). (ORPHA:2152)
- Developmental regression (HP:0002376): Loss of developmental skills, as manifested by loss of developmental milestones. Evidence: TAS. Frequency: Occasional (HP:0040283). (ORPHA:2152)
- Abnormal cerebral white matter morphology (HP:0002500): An abnormality of the cerebral white matter. Evidence: TAS. Frequency: Occasional (HP:0040283). (ORPHA:2152)
- Inability to walk (HP:0002540): Incapability to ambulate. Evidence: TAS. Frequency: Occasional (HP:0040283). (ORPHA:2152)
- Gastrointestinal dysmotility (HP:0002579): Abnormal intestinal contractions, such as spasms and intestinal paralysis, related to the loss of the ability of the gut to coordinate muscular activity because of endogenous or exogenous causes. Evidence: TAS. Frequency: Occasional (HP:0040283). (ORPHA:2152)
- Recurrent infections (HP:0002719): Increased susceptibility to infections as manifested by repeated bouts of infection. Evidence: TAS. Frequency: Occasional (HP:0040283). (ORPHA:2152)
- Bruxism (HP:0003763): Bruxism is characterized by the grinding of the teeth including the clenching of the jaw and typically occur during sleep. Evidence: TAS. Frequency: Occasional (HP:0040283). (ORPHA:2152)
- Decreased circulating immunoglobulin concentration (HP:0004313): An abnormally decreased level of immunoglobulin in blood. Evidence: TAS. Frequency: Occasional (HP:0040283). (ORPHA:2152)
- Enterocolitis (HP:0004387): An inflammation of the colon and small intestine. However, most conditions are either categorized as Enteritis (inflammation of the small intestine) or Colitis (inflammation of the large intestine). Evidence: TAS. Frequency: Occasional (HP:0040283). (ORPHA:2152)
- Abnormal dental morphology (HP:0006482): An abnormality of the morphology of the tooth. Evidence: TAS. Frequency: Occasional (HP:0040283). (ORPHA:2152)
- Focal white matter lesions (HP:0007042). Evidence: TAS. Frequency: Occasional (HP:0040283). (ORPHA:2152)
- Large basal ganglia (HP:0007048): Increased size of the basal ganglia. Evidence: TAS. Frequency: Occasional (HP:0040283). (ORPHA:2152)
- Periventricular heterotopia (HP:0007165): A form of gray matter heterotopia were the mislocalized gray matter is typically located periventricularly, also sometimes called subependymal heterotopia. Periventricular means beside the ventricles. This is by far the most common location for heterotopia. Subependymal heterotopia present in a wide array of variations. There can be a small single node or a large number of nodes, can exist on either or both sides of the brain at any point along the higher ventricle margins, can be small or large, single or multiple, and can form a small node or a large wavy or curved mass. Evidence: TAS. Frequency: Occasional (HP:0040283). (ORPHA:2152)
- Atypical absence seizure (HP:0007270): An atypical absence seizure is a type of generalized non-motor (absence) seizure characterized by interruption of ongoing activities and reduced responsiveness. In comparison to a typical absence seizure, changes in tone may be more pronounced, onset and/or cessation may be less abrupt, and the duration of the ictus and post-ictal recovery may be longer. Although not always available, an EEG often demonstrates slow (<3 Hz), irregular, generalized spike-wave activity. Evidence: TAS. Frequency: Occasional (HP:0040283). (ORPHA:2152)
- Focal-onset seizure (HP:0007359): A focal-onset seizure is a type of seizure originating within networks limited to one hemisphere. They may be discretely localized or more widely distributed, and may originate in subcortical structures. Evidence: TAS. Frequency: Occasional (HP:0040283). (ORPHA:2152)
- EEG with spike-wave complexes (HP:0010850): Complexes of spikes (<70 ms) and sharp waves (70-200 ms), which are sharp transient waves that have a strong association with epilepsy, in cerebral electrical activity recorded along the scalp by electroencephalography (EEG). Evidence: TAS. Frequency: Occasional (HP:0040283). (ORPHA:2152)
- Enlarged cerebellum (HP:0012081): An abnormally increased size of the cerebellum compared to other brain structures. Evidence: TAS. Frequency: Occasional (HP:0040283). (ORPHA:2152)
- Abnormal hippocampus morphology (HP:0025100): Any structural anomaly of the hippocampus,. Evidence: TAS. Frequency: Occasional (HP:0040283). (ORPHA:2152)
- Dependency on intravenous nutrition (HP:0025156): Inability to be weaned from intravenous (parenteral) nutrition, as judged by the hydration status (urine output, blood urea nitrogen, creatinine, urine sodium concentration), ability to maintain weight, stool output, and serum electrolyte status. Evidence: TAS. Frequency: Occasional (HP:0040283). (ORPHA:2152)
- Focal cortical dysplasia (HP:0032046): A type of malformation of cortical development that primarily affects areas of neocortex. It can be identified on conventional magnetic resonance imaging as focal cortical thickening, abnormal gyration, and blurring between gray and white matter, often associated with clusters of heterotopic neurons. Evidence: TAS. Frequency: Occasional (HP:0040283). (ORPHA:2152)
- Hydrocele testis (HP:0000034): Accumulation of clear fluid in the between the layers of membrane (tunica vaginalis) surrounding the testis. Evidence: TAS. Frequency: Very rare (HP:0040284). (ORPHA:2152)
- Chordee (HP:0000041): A congenital anomaly of the penis characterized by ventral (i.e., downward), lateral, or ventrolateral curvature of the shaft and glans penis of more than 30 degrees. Evidence: TAS. Frequency: Very rare (HP:0040284). (ORPHA:2152)
- Bifid scrotum (HP:0000048): Midline indentation or cleft of the scrotum. Evidence: TAS. Frequency: Very rare (HP:0040284). (ORPHA:2152)
- Micropenis (HP:0000054): Abnormally small penis. At birth, the normal penis is about 3 cm (stretched length from pubic tubercle to tip of penis) with micropenis less than 2.0-2.5 cm. Evidence: TAS. Frequency: Very rare (HP:0040284). (ORPHA:2152)
- Cleft palate (HP:0000175): Cleft palate is a developmental defect of the palate resulting from a failure of fusion of the palatine processes and manifesting as a separation of the roof of the mouth (soft and hard palate). Evidence: TAS. Frequency: Very rare (HP:0040284). (ORPHA:2152)
- Bifid uvula (HP:0000193): Uvula separated into two parts most easily seen at the tip. Evidence: TAS. Frequency: Very rare (HP:0040284). (ORPHA:2152)
- Sensorineural hearing impairment (HP:0000407): A type of hearing impairment in one or both ears related to an abnormal functionality of the cochlear nerve. Evidence: TAS. Frequency: Very rare (HP:0040284). (ORPHA:2152)
- Oligomenorrhea (HP:0000876): Infrequent menses (less than 6 per year or more than 35 days between cycles). Evidence: TAS. Frequency: Very rare (HP:0040284). (ORPHA:2152)
- Septate vagina (HP:0001153): The presence of a vaginal septum, thereby creating a vaginal duplication. The septum is longitudinal in the majority of cases. Evidence: TAS. Frequency: Very rare (HP:0040284). (ORPHA:2152)
- Dysphagia (HP:0002015): Difficulty in swallowing. Evidence: TAS. Frequency: Very rare (HP:0040284). (ORPHA:2152)
- Recurrent fractures (HP:0002757): The repeated occurrence of bone fractures (implying an abnormally increased tendency for fracture). Evidence: TAS. Frequency: Very rare (HP:0040284). (ORPHA:2152)
- Tracheal stenosis (HP:0002777). Evidence: TAS. Frequency: Very rare (HP:0040284). (ORPHA:2152)
- Pulmonary artery sling (HP:0004961): An anomalous origin of the left pulmonary artery, such that it arises from the posterior aspect of the right pulmonary artery and passes between the trachea and esophagus to reach the left hilum. Evidence: TAS. Frequency: Very rare (HP:0040284). (ORPHA:2152)
- Anterior plagiocephaly (HP:0011326): Asymmetry of the anterior part of the skull. Evidence: TAS. Frequency: Very rare (HP:0040284). (ORPHA:2152)
- Webbed penis (HP:0030264): Ventral skinfold extending from penis to scrotum. Evidence: TAS. Frequency: Very rare (HP:0040284). (ORPHA:2152)
- Cleft hard palate (HP:0410005). Evidence: TAS. Frequency: Very rare (HP:0040284). (ORPHA:2152)
- Submucous cleft of soft and hard palate (HP:0410031): Soft and hard-palate submucous clefts are characterized by bony defects in the midline of the soft and hard palate that are covered by the lining (ie mucous membrane) of the roof of the mouth. Evidence: TAS. Frequency: Very rare (HP:0040284). (ORPHA:2152)
- Urinary incontinence (HP:0000020): Loss of the ability to control the urinary bladder leading to involuntary urination. Evidence: TAS. Frequency: Frequent (HP:0040282). (ORPHA:2152)
- Cryptorchidism (HP:0000028): Testis in inguinal canal. That is, absence of one or both testes from the scrotum owing to failure of the testis or testes to descend through the inguinal canal to the scrotum. Evidence: TAS. Frequency: Frequent (HP:0040282). (ORPHA:2152)